- Pulmonary infiltrates (HP:0002113). Evidence: TAS. Frequency: Very frequent (HP:0040281). (ORPHA:90060)
- Weight loss (HP:0001824): Reduction of total body weight. Evidence: TAS. Frequency: Frequent (HP:0040282). (ORPHA:90060)
- Anemia (HP:0001903): A reduction in erythrocytes volume or hemoglobin concentration. Evidence: TAS. Frequency: Frequent (HP:0040282). (ORPHA:90060)
- Fever (HP:0001945): Body temperature elevated above the normal range. Evidence: TAS. Frequency: Frequent (HP:0040282). (ORPHA:90060)
- Hemoptysis (HP:0002105): Coughing up (expectoration) of blood or blood-streaked sputum from the larynx, trachea, bronchi, or lungs. Evidence: TAS. Frequency: Frequent (HP:0040282). (ORPHA:90060)
- Autoimmunity (HP:0002960): The occurrence of an immune reaction against the organism's own cells or tissues. Evidence: TAS. Frequency: Frequent (HP:0040282). (ORPHA:90060)
- Elevated erythrocyte sedimentation rate (HP:0003565): An increased erythrocyte sedimentation rate (ESR). The ESR is a test that measures the distance that erythrocytes have fallen after one hour in a vertical column of anticoagulated blood under the influence of gravity. The ESR is a nonspecific finding. An elevation may indicate inflammation or may be caused by any condition that elevates fibrinogen. Evidence: TAS. Frequency: Frequent (HP:0040282). (ORPHA:90060)
- Cough (HP:0012735): A sudden, audible expulsion of air from the lungs through a partially closed glottis, preceded by inhalation. Evidence: TAS. Frequency: Frequent (HP:0040282). (ORPHA:90060)
- Ground-glass opacification (HP:0025179): On chest radiographs, ground-glass opacity appears as an area of hazy increased lung opacity, usually extensive, within which margins of pulmonary vessels may be indistinct. On CT scans, it appears as hazy increased opacity of lung, with preservation of bronchial and vascular margins. It is caused by partial filling of airspaces, interstitial thickening (due to fluid, cells, and/or fibrosis), partial collapse of alveoli, increased capillary blood volume, or a combination of these, the common factor being the partial displacement of air. Ground-glass opacity is less opaque than consolidation, in which bronchovascular margins are obscured. Evidence: TAS. Frequency: Frequent (HP:0040282). (ORPHA:90060)
- Proteinuria (HP:0000093): Increased levels of protein in the urine. Evidence: TAS. Frequency: Occasional (HP:0040283). (ORPHA:90060)
- Abnormality of head or neck (HP:0000152): An abnormality of head and neck. Evidence: TAS. Frequency: Occasional (HP:0040283). (ORPHA:90060)
- Abnormality of the nervous system (HP:0000707): An abnormality of the nervous system. Evidence: TAS. Frequency: Occasional (HP:0040283). (ORPHA:90060)
- Hematuria (HP:0000790): The presence of blood in the urine. Hematuria may be gross hematuria (visible to the naked eye) or microscopic hematuria (detected by dipstick or microscopic examination of the urine). Evidence: TAS. Frequency: Occasional (HP:0040283). (ORPHA:90060)
- Abnormality of the skeletal system (HP:0000924): An abnormality of the skeletal system. Evidence: TAS. Frequency: Occasional (HP:0040283). (ORPHA:90060)
- Abnormality of the skin (HP:0000951): An abnormality of the skin. Evidence: TAS. Frequency: Occasional (HP:0040283). (ORPHA:90060)
- Thrombocytopenia (HP:0001873): A reduction in the number of circulating thrombocytes. Evidence: TAS. Frequency: Occasional (HP:0040283). (ORPHA:90060)
- Increased total leukocyte count (HP:0001974): An abnormal increase in the number of leukocytes in the blood. Evidence: TAS. Frequency: Occasional (HP:0040283). (ORPHA:90060)
- Dyspnea (HP:0002094): Difficult or labored breathing. Dyspnea is a subjective feeling only the patient can rate, e.g., on a Borg scale. Evidence: TAS. Frequency: Occasional (HP:0040283). (ORPHA:90060)
- Rheumatoid factor positive (HP:0002923): The presence in the serum of an autoantibody directed against the Fc portion of IgG. Evidence: TAS. Frequency: Occasional (HP:0040283). (ORPHA:90060)
- Elevated circulating creatinine concentration (HP:0003259): An increased amount of creatinine in the blood. Evidence: TAS. Frequency: Occasional (HP:0040283). (ORPHA:90060)
- Antineutrophil antibody positivity (HP:0003453): The presence of autoantibodies in the serum that react against neutrophils. Evidence: TAS. Frequency: Occasional (HP:0040283). (ORPHA:90060)
- Antinuclear antibody positivity (HP:0003493): The presence of autoantibodies in the serum that react against nuclei or nuclear components. Evidence: TAS. Frequency: Occasional (HP:0040283). (ORPHA:90060)
- Antiphospholipid antibody positivity (HP:0003613): The presence of circulating autoantibodies to phospholipids. Evidence: TAS. Frequency: Occasional (HP:0040283). (ORPHA:90060)
- Respiratory failure requiring assisted ventilation (HP:0004887): A state of respiratory distress that requires a life saving intervention in the form of gaining airway access and instituting positive pressure ventilation. Evidence: TAS. Frequency: Occasional (HP:0040283). (ORPHA:90060)
- Decreased circulating complement C3 concentration (HP:0005421): Concentration of the complement component C3 in the blood circulation below the lower limit of normal. Evidence: TAS. Frequency: Occasional (HP:0040283). (ORPHA:90060)
- Hypoxemia (HP:0012418): An abnormally low level of blood oxygen. Evidence: TAS. Frequency: Occasional (HP:0040283). (ORPHA:90060)
- Decreased circulating complement C4 concentration (HP:0045042): Concentration of the complement component C4 in the blood circulation below the lower limit of normal. Evidence: TAS. Frequency: Occasional (HP:0040283). (ORPHA:90060)
- Increased DLCO (HP:0045050): Increased ability of the lungs to transfer gas from inspired air to the bloodstream as measured by the diffusing capacity of the lungs for carbon monoxide (DLCO) test. Evidence: TAS. Frequency: Occasional (HP:0040283). (ORPHA:90060)
- Chest pain (HP:0100749): An unpleasant sensation characterized by physical discomfort (such as pricking, throbbing, or aching) localized to the chest. Evidence: TAS. Frequency: Occasional (HP:0040283). (ORPHA:90060)
- Restrictive ventilatory defect (HP:0002091): A functional defect characterized by reduced total lung capacity (TLC) not associated with abnormalities of expiratory airflow or airway resistance. Spirometrically, a restrictive defect is defined as FEV1 (forced expiratory volume in 1 second) and FVC (forced vital capacity) less than 80 per cent. Restrictive lung disease may be caused by alterations in lung parenchyma or because of a disease of the pleura, chest wall, or neuromuscular apparatus. Evidence: TAS. Frequency: Very rare (HP:0040284). (ORPHA:90060)
- Pulmonary fibrosis (HP:0002206): Replacement of normal lung tissues by fibroblasts and collagen. Evidence: TAS. Frequency: Very rare (HP:0040284). (ORPHA:90060)
- Airway obstruction (HP:0006536): Obstruction of conducting airways of the lung. Evidence: TAS. Frequency: Very rare (HP:0040284). (ORPHA:90060)
- Irregular septal thickening on pulmonary HRCT (HP:0025174): Thickening of the interlobular septa of the lungs as seen on a high-resolution computed tomography scan with an irregular appearance of the interlobular septa. THis feature is often associated with distortion of lung architecture. Evidence: TAS. Frequency: Very rare (HP:0040284). (ORPHA:90060)
- Pulmonary venous hypertension (HP:0030950): An abnormal increase in pressure in the pulmonary veins, usually as a result of left atrial hypertension. Evidence: TAS. Frequency: Very rare (HP:0040284). (ORPHA:90060)
These phenotypes are associated with the disease Diffuse alveolar hemorrhage (ORPHA:90060).